Phenotypes associated with the disease Body integrity dysphoria (ORPHA:623789):
- Emotional lability (HP:0000712): Unstable emotional experiences and frequent mood changes; emotions that are easily aroused, intense, and/or disproportionate to events and circumstances. Evidence: TAS. Frequency: Occasional (HP:0040283). (ORPHA:623789)
- Limb muscle weakness (HP:0003690): Reduced strength and weakness of the muscles of the arms and legs. Evidence: TAS. Frequency: Occasional (HP:0040283). (ORPHA:623789)
- Herniation of intervertebral nuclei (HP:0008441): The presence of one or more herniated nucleus pulposus of intervertebral disk. Evidence: TAS. Frequency: Occasional (HP:0040283). (ORPHA:623789)
- Anxiety (HP:0000739): Intense feelings of nervousness, tension, or panic often arise in response to interpersonal stresses. There is worry about the negative effects of past unpleasant experiences and future negative possibilities. Individuals may feel fearful, apprehensive, or threatened by uncertainty, and they may also have fears of falling apart or losing control. Evidence: TAS. Frequency: Very rare (HP:0040284). (ORPHA:623789)
- Abnormal eating behavior (HP:0100738): Abnormal eating habits involve excessive or insufficient consumption of food, or any other abnormal pattern of food consumption. Evidence: TAS. Frequency: Very rare (HP:0040284). (ORPHA:623789)
- Schizophrenia (HP:0100753): A mental disorder characterized by a disintegration of thought processes and emotional responsiveness. It most commonly manifests as auditory hallucinations, paranoid or bizarre delusions, or disorganized speech and thinking. It is accompanied by significant social or occupational dysfunction. The onset of symptoms typically occurs in young adulthood, with a global lifetime prevalence of about 1%. This term is not a helpful parent term to describe abnormal experiences. Evidence: TAS. Frequency: Very rare (HP:0040284). (ORPHA:623789)